- Hand monodactyly (HP:0004058). Evidence: TAS. (OMIM:228250)
- Aplasia of the ulna (HP:0003982): Missing ulna bone associated with congenital failure of development. Evidence: TAS. (OMIM:228250)
- Autosomal recessive inheritance (HP:0000007): A mode of inheritance that is observed for traits related to a gene encoded on one of the autosomes (i.e., the human chromosomes 1-22) in which a trait manifests in individuals with two pathogenic alleles, either homozygotes (two copies of the same mutant allele) or compound heterozygotes (whereby each copy of a gene has a distinct mutant allele). Evidence: TAS. (OMIM:228250)
- Split hand (HP:0001171): A condition in which middle parts of the hand (fingers and metacarpals) are missing giving a cleft appearance. The severity is very variable ranging from slightly hypoplastic middle fingers over absent middle fingers as far as oligo- or monodactyl hands. Evidence: TAS. (OMIM:228250)
- Bifid femur (HP:0010443): A bifid or bifurcated appearance of the femur as seen on x-rays, possible appearing as a more or less severe bowing of the upper leg. Might be associated with hip dysplasia on the affected side. Evidence: TAS. (OMIM:228250)
- Absent tibia (HP:0009556): Absence of the tibia. Evidence: TAS. (OMIM:228250)
- Foot monodactyly (HP:0200054). Evidence: TAS. (OMIM:228250)
These phenotypes are associated with the disease Gollop-Wolfgang complex (OMIM:228250).